- Bilateral tonic-clonic seizure (HP:0002069): A bilateral tonic-clonic seizure is a seizure defined by a tonic (bilateral increased tone, lasting seconds to minutes) and then a clonic (bilateral sustained rhythmic jerking) phase. Evidence: PCS. Frequency: 4/9. (PMID:18756473)
- Juvenile onset (HP:0003621): Onset of signs or symptoms of disease between the age of 5 and 15 years. Evidence: PCS. Frequency: 1/1. (PMID:18756473)
- Seizure (HP:0001250): A seizure is an intermittent abnormality of nervous system physiology characterized by a transient occurrence of signs and/or symptoms due to abnormal excessive or synchronous neuronal activity in the brain. Evidence: PCS. Frequency: 9/9. (PMID:18756473)
- Focal impaired awareness seizure (HP:0002384): Focal impaired awareness seizure (or focal seizure with impaired or lost awareness) is a type of focal-onset seizure characterized by some degree (which may be partial) of impairment of the person's awareness of themselves or their surroundings at any point during the seizure. Evidence: PCS. Frequency: 2/9. (PMID:18756473)
- Febrile seizure (within the age range of 3 months to 6 years) (HP:0002373): A febrile seizure is any type of seizure (most often a generalized tonic-clonic seizure) occurring with fever (at least 38 degrees Celsius) but in the absence of central nervous system infection, severe metabolic disturbance or other alternative precipitant in children between the ages of 3 months and 6 years. Evidence: PCS. Frequency: 1/9. (PMID:18756473)
- Generalized non-motor (absence) seizure (HP:0002121): A generalized non-motor (absence) seizure is a type of a type of dialeptic seizure that is of electrographically generalized onset. It is a generalized seizure characterized by an interruption of activities, a blank stare, and usually the person will be unresponsive when spoken to. Any ictal motor phenomena are minor in comparison to these non-motor features. Evidence: PCS. Frequency: 2/9. (PMID:18756473)
- Autosomal dominant inheritance (HP:0000006): A mode of inheritance that is observed for traits related to a gene encoded on one of the autosomes (i.e., the human chromosomes 1-22) in which a trait manifests in heterozygotes. In the context of medical genetics, an autosomal dominant disorder is caused when a single copy of the mutant allele is present. Males and females are affected equally, and can both transmit the disorder with a risk of 50% for each child of inheriting the mutant allele. Evidence: PCS. (PMID:18756473)
- Myoclonus (HP:0001336): Very brief, involuntary random muscular contractions occurring at rest, in response to sensory stimuli, or accompanying voluntary movements. Evidence: PCS. Frequency: 4/9. (PMID:18756473)
These phenotypes are associated with the disease epilepsy, idiopathic generalized, susceptibility to, 8 (OMIM:612899).